- Thrombocytopenia (HP:0001873): A reduction in the number of circulating thrombocytes. Evidence: TAS. Frequency: Very frequent (HP:0040281). (ORPHA:99827)
- Fever (HP:0001945): Body temperature elevated above the normal range. Evidence: TAS. Frequency: Very frequent (HP:0040281). (ORPHA:99827)
- Increased circulating IgM concentration (HP:0003496): An abnormally increased level of immunoglobulin M in blood. Evidence: TAS. Frequency: Very frequent (HP:0040281). (ORPHA:99827)
- Capillary leak (HP:0030005): An acute phenomenon characterized by hypotension and anasarca due to the loss of plasma volume into peripheral tissues, with evidence of decreased plasma volume (hemoconcentration) and protein loss from the intravascular space (hypoalbuminemia) during acute episodes. Evidence: TAS. Frequency: Very frequent (HP:0040281). (ORPHA:99827)
- Epistaxis (HP:0000421): Epistaxis, or nosebleed, refers to a hemorrhage localized in the nose. Evidence: TAS. Frequency: Frequent (HP:0040282). (ORPHA:99827)
- Diarrhea (HP:0002014): Abnormally increased frequency (usually defined as three or more) loose or watery bowel movements a day. Evidence: TAS. Frequency: Frequent (HP:0040282). (ORPHA:99827)
- Nausea and vomiting (HP:0002017): Nausea is a commonly encountered symptom that has been defined as an unpleasant painless subjective feeling that one will imminently vomit. Vomiting has been defined as the forceful expulsion of the contents of the stomach, duodenum, or jejunum through the oral cavity. While nausea and vomiting are often thought to exist on a temporal continuum, this is not always the case. There are situations when severe nausea may be present without emesis and less frequently, when emesis may be present without preceding nausea. Evidence: TAS. Frequency: Frequent (HP:0040282). (ORPHA:99827)
- Abdominal pain (HP:0002027): An unpleasant sensation characterized by physical discomfort (such as pricking, throbbing, or aching) and perceived to originate in the abdomen. Evidence: TAS. Frequency: Frequent (HP:0040282). (ORPHA:99827)
- Anorexia (HP:0002039): Lack of desire to eat (loss of appetite). Evidence: TAS. Frequency: Frequent (HP:0040282). (ORPHA:99827)
- Hepatomegaly (HP:0002240): Abnormally increased size of the liver. Evidence: TAS. Frequency: Frequent (HP:0040282). (ORPHA:99827)
- Headache (HP:0002315): Cephalgia, or pain sensed in various parts of the head, not confined to the area of distribution of any nerve. Evidence: TAS. Frequency: Frequent (HP:0040282). (ORPHA:99827)
- Elevated circulating creatine kinase activity (HP:0003236): The activity of creatine kinase in the blood circulation is above the upper limit of normal. Evidence: TAS. Frequency: Frequent (HP:0040282). (ORPHA:99827)
- Increased circulating IgG concentration (HP:0003237): An abnormally increased level of immunoglobulin G in blood. Evidence: TAS. Frequency: Frequent (HP:0040282). (ORPHA:99827)
- Myalgia (HP:0003326): Pain in muscle. Evidence: TAS. Frequency: Frequent (HP:0040282). (ORPHA:99827)
- Prolonged partial thromboplastin time (HP:0003645): Increased time to coagulation in the partial thromboplastin time (PTT) test, a measure of the intrinsic and common coagulation pathways. Phospholipid, and activator, and calcium are mixed into an anticoagulated plasma sample, and the time is measured until a thrombus forms. Evidence: TAS. Frequency: Frequent (HP:0040282). (ORPHA:99827)
- Viremia (HP:0020071): The presence of virus in the blood. Evidence: TAS. Frequency: Frequent (HP:0040282). (ORPHA:99827)
- Stiff neck (HP:0025258): A sensation of tightness in the neck when attempting to move it, especially after a period of inactivity. Neck stiffness often involves soreness and difficulty moving the neck, especially when trying to turn the head to the side. Evidence: TAS. Frequency: Frequent (HP:0040282). (ORPHA:99827)
- Increased circulating lactate dehydrogenase concentration (HP:0025435): An elevated level of the enzyme lactate dehydrogenase in the blood circulation. Evidence: TAS. Frequency: Frequent (HP:0040282). (ORPHA:99827)
- Neck pain (HP:0030833): An unpleasant sensation characterized by physical discomfort (such as pricking, throbbing, or aching) localized to the neck. Evidence: TAS. Frequency: Frequent (HP:0040282). (ORPHA:99827)
- Decreased prothrombin time (HP:0032198): Abnormally short time to coagulation in the prothrombin time test, which is a measure of the extrinsic pathway of coagulation. The results of the prothrombin time test are often expressed in terms of the International normalized ratio (INR), which is calculated as a ratio of the patient's prothrombin time (PT) to a control PT standardized for the potency of the thromboplastin reagent developed by the World Health Organization (WHO) using the formula: INR is equal to Patient PT divided by Control PT. Evidence: TAS. Frequency: Frequent (HP:0040282). (ORPHA:99827)
- Ocular pain (HP:0200026): An unpleasant sensation characterized by physical discomfort (such as pricking, throbbing, or aching) localized to the eye. Evidence: TAS. Frequency: Frequent (HP:0040282). (ORPHA:99827)
- Gingival bleeding (HP:0000225): Hemorrhage affecting the gingiva. Evidence: TAS. Frequency: Occasional (HP:0040283). (ORPHA:99827)
- Conjunctivitis (HP:0000509): Inflammation of the conjunctiva. Evidence: TAS. Frequency: Occasional (HP:0040283). (ORPHA:99827)
- Photophobia (HP:0000613): Excessive sensitivity to light with the sensation of discomfort or pain in the eyes due to exposure to bright light. Evidence: TAS. Frequency: Occasional (HP:0040283). (ORPHA:99827)
- Abnormality of the nervous system (HP:0000707): An abnormality of the nervous system. Evidence: TAS. Frequency: Occasional (HP:0040283). (ORPHA:99827)
- Emotional lability (HP:0000712): Unstable emotional experiences and frequent mood changes; emotions that are easily aroused, intense, and/or disproportionate to events and circumstances. Evidence: TAS. Frequency: Occasional (HP:0040283). (ORPHA:99827)
- Agitation (HP:0000713): A state of excessive motor activity that is associated with mental distress or a feeling of substantial unease or inner tension. Distinguished from restlessness by the increased level of emotional distress and negative intensity of the experience. Agitation has a significant level of physical activity that is typically threatening to the self or others. Evidence: TAS. Frequency: Occasional (HP:0040283). (ORPHA:99827)
- Hematuria (HP:0000790): The presence of blood in the urine. Hematuria may be gross hematuria (visible to the naked eye) or microscopic hematuria (detected by dipstick or microscopic examination of the urine). Evidence: TAS. Frequency: Occasional (HP:0040283). (ORPHA:99827)
- Hypertension (HP:0000822): The presence of chronic increased pressure in the systemic arterial system. Evidence: TAS. Frequency: Occasional (HP:0040283). (ORPHA:99827)
- Jaundice (HP:0000952): Yellow pigmentation of the skin due to bilirubin, which in turn is the result of increased bilirubin concentration in the bloodstream. Evidence: TAS. Frequency: Occasional (HP:0040283). (ORPHA:99827)
- Hyperhidrosis (HP:0000975): Abnormal excessive perspiration (sweating) despite the lack of appropriate stimuli like hot and humid weather. Evidence: TAS. Frequency: Occasional (HP:0040283). (ORPHA:99827)
- Purpura (HP:0000979): Purpura (from Latin: purpura, meaning purple) is the appearance of red or purple discolorations on the skin that do not blanch on applying pressure. They are caused by bleeding underneath the skin. This term refers to an abnormally increased susceptibility to developing purpura. Purpura are larger than petechiae. Evidence: TAS. Frequency: Occasional (HP:0040283). (ORPHA:99827)
- Coma (HP:0001259): The complete absence of wakefulness and consciousness, which is evident through a lack of response to any form of external stimuli. Evidence: TAS. Frequency: Occasional (HP:0040283). (ORPHA:99827)
- Excessive daytime somnolence (HP:0001262): A state of abnormally strong desire for sleep during the daytime. Evidence: TAS. Frequency: Occasional (HP:0040283). (ORPHA:99827)
- Confusion (HP:0001289): Lack of clarity and coherence of thought, perception, understanding, or action. Evidence: TAS. Frequency: Occasional (HP:0040283). (ORPHA:99827)
- Hepatic failure (HP:0001399). Evidence: TAS. Frequency: Occasional (HP:0040283). (ORPHA:99827)
- Tachycardia (HP:0001649): A rapid heartrate that exceeds the range of the normal resting heartrate for age. Evidence: TAS. Frequency: Occasional (HP:0040283). (ORPHA:99827)
- Bradycardia (HP:0001662): A slower than normal heart rate (in adults, slower than 60 beats per minute). Evidence: TAS. Frequency: Occasional (HP:0040283). (ORPHA:99827)
- Splenomegaly (HP:0001744): Abnormal increased size of the spleen. Evidence: TAS. Frequency: Occasional (HP:0040283). (ORPHA:99827)
- Decreased total leukocyte count (HP:0001882): An abnormal decreased number of leukocytes in the blood. Evidence: TAS. Frequency: Occasional (HP:0040283). (ORPHA:99827)
- Increased total leukocyte count (HP:0001974): An abnormal increase in the number of leukocytes in the blood. Evidence: TAS. Frequency: Occasional (HP:0040283). (ORPHA:99827)
- Hemoptysis (HP:0002105): Coughing up (expectoration) of blood or blood-streaked sputum from the larynx, trachea, bronchi, or lungs. Evidence: TAS. Frequency: Occasional (HP:0040283). (ORPHA:99827)
- Hematemesis (HP:0002248): The vomiting of blood. Evidence: TAS. Frequency: Occasional (HP:0040283). (ORPHA:99827)
- Melena (HP:0002249): The passage of blackish, tarry feces associated with gastrointestinal hemorrhage. Melena occurs if the blood remains in the colon long enough for it to be broken down by colonic bacteria. One degradation product, hematin, imbues the stool with a blackish color. Thus, melena generally occurs with bleeding from the upper gastrointestinal tract (e.g., stomach ulcers or duodenal ulcers), since the blood usually remains in the gut for a longer period of time than with lower gastrointestinal bleeding. Evidence: TAS. Frequency: Occasional (HP:0040283). (ORPHA:99827)
- Vertigo (HP:0002321): An abnormal sensation of spinning while the body is actually stationary. Evidence: TAS. Frequency: Occasional (HP:0040283). (ORPHA:99827)
- Fasciculations (HP:0002380): Fasciculations are observed as small, local, involuntary muscle contractions (twitching) visible under the skin. Fasciculations result from increased irritability of an axon (which in turn is often a manifestation of disease of a motor neuron). This leads to sporadic discharges of all the muscle fibers controlled by the axon in isolation from other motor units. Evidence: TAS. Frequency: Occasional (HP:0040283). (ORPHA:99827)
- Hypotension (HP:0002615): Low Blood Pressure, vascular hypotension. Evidence: TAS. Frequency: Occasional (HP:0040283). (ORPHA:99827)
- Lymphadenopathy (HP:0002716): Enlargement (swelling) of a lymph node. Evidence: TAS. Frequency: Occasional (HP:0040283). (ORPHA:99827)
- Chills (HP:0025143): A sudden sensation of feeling cold. Evidence: TAS. Frequency: Occasional (HP:0040283). (ORPHA:99827)
- Ecchymosis (HP:0031364): A purpuric lesion that is larger than 1 cm in diameter. Evidence: TAS. Frequency: Occasional (HP:0040283). (ORPHA:99827)
- Recurrent singultus (HP:0100247): A contraction of the diaphragm that repeats several times per minute. In humans, the abrupt rush of air into the lungs causes the epiglottis to close, creating a hic sound. Also known as synchronous diaphragmatic flutter (SDF), or singultus, from the Latin singult, the act of catching one's breath while sobbing. The hiccup is an involuntary action involving a reflex arc. Evidence: TAS. Frequency: Occasional (HP:0040283). (ORPHA:99827)
- Epididymitis (HP:0000031): The presence of inflammation of the epididymis. Evidence: TAS. Frequency: Very rare (HP:0040284). (ORPHA:99827)
- Proteinuria (HP:0000093): Increased levels of protein in the urine. Evidence: TAS. Frequency: Very rare (HP:0040284). (ORPHA:99827)
- Retinal hemorrhage (HP:0000573): Bleeding located within the retina. Retinal hemorrhages range from the smallest dot and blot hemorrhage to massive sub-hyaloid hemorrhage. Evidence: TAS. Frequency: Very rare (HP:0040284). (ORPHA:99827)
- Adrenal insufficiency (HP:0000846): Insufficient production of steroid hormones (primarily cortisol) by the adrenal glands. Evidence: TAS. Frequency: Very rare (HP:0040284). (ORPHA:99827)
- Cholecystitis (HP:0001082): The presence of inflammatory changes in the gallbladder. Evidence: TAS. Frequency: Very rare (HP:0040284). (ORPHA:99827)
- Ascites (HP:0001541): Accumulation of fluid in the peritoneal cavity (between the layers of the peritoneum that lines the abdomen). Evidence: TAS. Frequency: Very rare (HP:0040284). (ORPHA:99827)
- Pericardial effusion (HP:0001698): Accumulation of fluid within the pericardium. Evidence: TAS. Frequency: Very rare (HP:0040284). (ORPHA:99827)
- Acute pancreatitis (HP:0001735): A acute form of pancreatitis. Evidence: TAS. Frequency: Very rare (HP:0040284). (ORPHA:99827)
- Pancytopenia (HP:0001876): An abnormal reduction in numbers of all blood cell types (red blood cells, white blood cells, and platelets). Evidence: TAS. Frequency: Very rare (HP:0040284). (ORPHA:99827)
- Pulmonary arterial hypertension (HP:0002092): Pulmonary hypertension is defined mean pulmonary artery pressure of 25mmHg or more and pulmonary capillary wedge pressure of 15mmHg or less when measured by right heart catheterisation at rest and in a supine position. Evidence: TAS. Frequency: Very rare (HP:0040284). (ORPHA:99827)
- Arthralgia (HP:0002829): Joint pain. Evidence: TAS. Frequency: Very rare (HP:0040284). (ORPHA:99827)
- Abnormal left ventricular function (HP:0005162): Inability of the left ventricle to perform its normal physiologic function. Failure is either due to an inability to contract the left ventricle or the inability to relax completely and fill with blood during diastole. Evidence: TAS. Frequency: Very rare (HP:0040284). (ORPHA:99827)
- Spontaneous hematomas (HP:0007420): Spontaneous development of hematomas (hematoma) or bruises without significant trauma. Evidence: TAS. Frequency: Very rare (HP:0040284). (ORPHA:99827)
- Internal hemorrhage (HP:0011029): The presence of hemorrhage within the body. Evidence: TAS. Frequency: Very rare (HP:0040284). (ORPHA:99827)
- Bundle branch block (HP:0011710): Block of conduction of electrical impulses along the Bundle of His or along one of its bundle branches. Evidence: TAS. Frequency: Very rare (HP:0040284). (ORPHA:99827)
- Parotitis (HP:0011850): Inflammation of the parotid gland. Evidence: TAS. Frequency: Very rare (HP:0040284). (ORPHA:99827)
- Hemoperitoneum (HP:0011854): Accumulation of blood in the peritoneal cavity owing to internal hemorrhage. Evidence: TAS. Frequency: Very rare (HP:0040284). (ORPHA:99827)
- Subconjunctival hemorrhage (HP:0011896): Bleeding beneath the mucous membrane that lines the inner surface of the eyelid. Evidence: TAS. Frequency: Very rare (HP:0040284). (ORPHA:99827)
- Increased total neutrophil count (HP:0011897): Abnormal increase of absolute number of neutrophils in the blood, per microliter, compared to a reference range for a given sex and age-group. Evidence: TAS. Frequency: Very rare (HP:0040284). (ORPHA:99827)
- Hemothorax (HP:0012151): The presence of blood in the pleural space. Evidence: TAS. Frequency: Very rare (HP:0040284). (ORPHA:99827)
- Erythema nodosum (HP:0012219): An erythematous eruption commonly associated with drug reactions or infection and characterized by inflammatory nodules that are usually tender, multiple, and bilateral. Evidence: TAS. Frequency: Very rare (HP:0040284). (ORPHA:99827)
- Morbilliform rash (HP:0012282): An exanthema consisting of widespread pink-to-red macules (flat spots of 2-10 mm in diameter) or papules (red bumps) that blanch with pressure. The macules and papules may cluster and merge to form sheets over several days. Evidence: TAS. Frequency: Very rare (HP:0040284). (ORPHA:99827)
- Myocarditis (HP:0012819): Inflammation of the myocardium. Evidence: TAS. Frequency: Very rare (HP:0040284). (ORPHA:99827)
- Diffuse alveolar hemorrhage (HP:0025420): A type of of pulmonary hemorrhage that originates from the pulmonary microcirculation, including the alveolar capillaries, arterioles, and venules. It presents with hemoptysis, anemia, diffuse lung infiltration, and acute respiratory failure. The diagnosis is confirmed by the observation of the accumulation of red blood cells, fibrin, or hemosiderin-laden macrophage in the alveolar space on pathologic biopsy. Hemosiderin, a product of hemoglobin degradation, appears at least 48-72 hours after bleeding and is helpful in distinguishing diffuse alveolar hemorrhage from surgical trauma. Mild interstitial thickening, organizing pneumonia, or diffuse alveolar damage can also be seen. Evidence: TAS. Frequency: Very rare (HP:0040284). (ORPHA:99827)
- Inappropriate antidiuretic hormone secretion (HP:0031218): A state of increased circulating antidiuretic hormone despite hyponatremia and hypo-osmolality with normal or increased plasma volume. Evidence: TAS. Frequency: Very rare (HP:0040284). (ORPHA:99827)
- Subdural hemorrhage (HP:0100309): Hemorrhage occurring between the dura mater and the arachnoid mater. Evidence: TAS. Frequency: Very rare (HP:0040284). (ORPHA:99827)
- Orchitis (HP:0100796): Testicular inflammation. Evidence: TAS. Frequency: Very rare (HP:0040284). (ORPHA:99827)
These phenotypes are associated with the disease Crimean-Congo hemorrhagic fever (ORPHA:99827).